Phenotypes associated with the disease cardiomyopathy, dilated, 100 (OMIM:620247):
- Middle age onset (HP:0003596): A type of adult onset with onset of symptoms at the age of 40 to 60 years. Evidence: PCS. Frequency: 5/8. (PMID:36657711)
- Young adult onset (HP:0011462): Onset of disease at the age of between 16 and 40 years. Evidence: PCS. Frequency: 3/8. (PMID:36657711)
- Second degree atrioventricular block (HP:0011706): An intermittent atrioventricular block with failure of some atrial impulses to conduct to the ventricles, i.e., some but not all atrial impulses are conducted through the atrioventricular node and trigger ventricular contraction. Evidence: PCS. Frequency: 3/8. (PMID:36657711)
- Premature ventricular contraction (HP:0006682): Premature ventricular contractions (PVC) or ventricular extrasystoles are premature contractions of the heart that arise in response to an impulse in the ventricles rather than the normal impulse from the sinoatrial (SA) node. Evidence: PCS. Frequency: 2/8. (PMID:36657711)
- Congestive heart failure (HP:0001635): The presence of an abnormality of cardiac function that is responsible for the failure of the heart to pump blood at a rate that is commensurate with the needs of the tissues or a state in which abnormally elevated filling pressures are required for the heart to do so. Heart failure is frequently related to a defect in myocardial contraction. Evidence: PCS. Frequency: 3/8. (PMID:36657711)
- Reduced left ventricular ejection fraction (HP:0012664): A diminution of the volumetric fraction of blood pumped out of the ventricle with each cardiac cycle. Evidence: PCS. Frequency: 8/8. (PMID:36657711)
- Atrial septal defect (HP:0001631): Atrial septal defect (ASD) is a congenital abnormality of the interatrial septum that enables blood flow between the left and right atria via the interatrial septum. Evidence: PCS. Frequency: 2/8. (PMID:36657711)
- Autosomal dominant inheritance (HP:0000006): A mode of inheritance that is observed for traits related to a gene encoded on one of the autosomes (i.e., the human chromosomes 1-22) in which a trait manifests in heterozygotes. In the context of medical genetics, an autosomal dominant disorder is caused when a single copy of the mutant allele is present. Males and females are affected equally, and can both transmit the disorder with a risk of 50% for each child of inheriting the mutant allele. Evidence: PCS. (PMID:36657711)
- Dilated cardiomyopathy (HP:0001644): Dilated cardiomyopathy (DCM) is defined by the presence of left ventricular dilatation and left ventricular systolic dysfunction in the absence of abnormal loading conditions (hypertension, valve disease) or coronary artery disease sufficient to cause global systolic impairment. Right ventricular dilation and dysfunction may be present but are not necessary for the diagnosis. Evidence: PCS. Frequency: 8/8. (PMID:36657711)